- Agitation (HP:0000713): A state of excessive motor activity that is associated with mental distress or a feeling of substantial unease or inner tension. Distinguished from restlessness by the increased level of emotional distress and negative intensity of the experience. Agitation has a significant level of physical activity that is typically threatening to the self or others. Evidence: TAS. Frequency: Occasional (HP:0040283). (ORPHA:276608)
- Hyperinsulinemic hypoglycemia (HP:0000825): An increased concentration of insulin combined with a decreased concentration of glucose in the blood. Evidence: TAS. Frequency: Very frequent (HP:0040281). (ORPHA:276608)
- Hyperinsulinemia (HP:0000842): An increased concentration of insulin in the blood. Evidence: TAS. Frequency: Frequent (HP:0040282). (ORPHA:276608)
- Hyperhidrosis (HP:0000975): Abnormal excessive perspiration (sweating) despite the lack of appropriate stimuli like hot and humid weather. Evidence: TAS. Frequency: Very frequent (HP:0040281). (ORPHA:276608)
- Pallor (HP:0000980): Abnormally pale skin. Evidence: TAS. Frequency: Very frequent (HP:0040281). (ORPHA:276608)
- Intellectual disability (HP:0001249): The term intellectual disability or intellectual developmental disorder is used to describe significantly sub-average intellectual and adaptive functioning based on clinical assessment and as measured by individually administered, appropriately normed, standardized and validated tests of intellectual functioning and adaptive behavior, with onset during the developmental period from infancy through adolescence. Evidence: TAS. Frequency: Occasional (HP:0040283). (ORPHA:276608)
- Seizure (HP:0001250): A seizure is an intermittent abnormality of nervous system physiology characterized by a transient occurrence of signs and/or symptoms due to abnormal excessive or synchronous neuronal activity in the brain. Evidence: TAS. Frequency: Occasional (HP:0040283). (ORPHA:276608)
- Lethargy (HP:0001254): A state of fatigue, either physical or mental slowness and sluggishness, with difficulties in initiating or performing simple tasks. Distinguished from apathy which implies indifference and a lack of desire or interest in the task. A person with lethargy may have the desire, but not the energy to engage in personal or socially relevant tasks. Evidence: TAS. Frequency: Very frequent (HP:0040281). (ORPHA:276608)
- Coma (HP:0001259): The complete absence of wakefulness and consciousness, which is evident through a lack of response to any form of external stimuli. Evidence: TAS. Frequency: Very frequent (HP:0040281). (ORPHA:276608)
- Headache (HP:0002315): Cephalgia, or pain sensed in various parts of the head, not confined to the area of distribution of any nerve. Evidence: TAS. Frequency: Occasional (HP:0040283). (ORPHA:276608)
- Tremor (HP:0001337): An unintentional, oscillating to-and-fro muscle movement about a joint axis. Evidence: TAS. Frequency: Very frequent (HP:0040281). (ORPHA:276608)
- Tachycardia (HP:0001649): A rapid heartrate that exceeds the range of the normal resting heartrate for age. Evidence: TAS. Frequency: Very frequent (HP:0040281). (ORPHA:276608)
- Hypoketotic hypoglycemia (HP:0001985): A decreased concentration of glucose in the blood associated with a reduced concentration of ketone bodies. Evidence: TAS. Frequency: Very frequent (HP:0040281). (ORPHA:276608)
- Drowsiness (HP:0002329): Abnormal feeling of sleepiness or difficulty staying awake. Evidence: TAS. Frequency: Occasional (HP:0040283). (ORPHA:276608)
- Progressive neurologic deterioration (HP:0002344). Evidence: TAS. Frequency: Very frequent (HP:0040281). (ORPHA:276608)
- Fasting hypoglycemia (HP:0003162). Evidence: TAS. Frequency: Very frequent (HP:0040281). (ORPHA:276608)
- Generalized muscle weakness (HP:0003324): Generalized weakness or decreased strength of the muscles, affecting both distal and proximal musculature. Evidence: TAS. Frequency: Very frequent (HP:0040281). (ORPHA:276608)
- Increased body weight (HP:0004324): Abnormally increased body weight. Evidence: TAS. Frequency: Very frequent (HP:0040281). (ORPHA:276608)
- Pancreatic islet-cell hyperplasia (HP:0004510): Hyperplasia of the islets of Langerhans, i.e., of the regions of the pancreas that contain its endocrine cells. Evidence: TAS. Frequency: Very frequent (HP:0040281). (ORPHA:276608)
- Reactive hypoglycemia (HP:0012051): Hypoglycermia following a meal (or more generally, after intake of glucose). Evidence: TAS. Frequency: Frequent (HP:0040282). (ORPHA:276608)
- Fatigue (HP:0012378): A subjective feeling of tiredness characterized by a lack of energy and motivation. Evidence: TAS. Frequency: Very frequent (HP:0040281). (ORPHA:276608)
These phenotypes are associated with the disease Non-insulinoma pancreatogenous hypoglycemia syndrome (ORPHA:276608).